- Abnormality of blood and blood-forming tissues (HP:0001871): An abnormality of the hematopoietic system. Evidence: IEA. (OMIM:610460)
- Abnormality of metabolism/homeostasis (HP:0001939). Evidence: IEA. (OMIM:610460)
- Autosomal recessive inheritance (HP:0000007): A mode of inheritance that is observed for traits related to a gene encoded on one of the autosomes (i.e., the human chromosomes 1-22) in which a trait manifests in individuals with two pathogenic alleles, either homozygotes (two copies of the same mutant allele) or compound heterozygotes (whereby each copy of a gene has a distinct mutant allele). Evidence: TAS. (OMIM:610460)
These phenotypes are associated with the disease thiopurine S-methyltransferase deficiency (OMIM:610460).